Phenotypes associated with the disease Congenital amegakaryocytic thrombocytopenia (ORPHA:3319):
- Coarse facial features (HP:0000280): Absence of fine and sharp appearance of brows, nose, lips, mouth, and chin, usually because of rounded and heavy features or thickened skin with or without thickening of subcutaneous and bony tissues. Evidence: TAS. Frequency: Frequent (HP:0040282). (ORPHA:3319)
- Short neck (HP:0000470): Diminished length of the neck. Evidence: TAS. Frequency: Frequent (HP:0040282). (ORPHA:3319)
- Melanocytic nevus (HP:0000995): A oval and round, colored (usually medium-to dark brown, reddish brown, or flesh colored) lesion. Typically, a melanocytic nevus is less than 6 mm in diameter, but may be much smaller or larger. Evidence: TAS. Frequency: Frequent (HP:0040282). (ORPHA:3319)
- Abnormal cardiac septum morphology (HP:0001671): An anomaly of the intra-atrial or intraventricular septum. Evidence: TAS. Frequency: Occasional (HP:0040283). (ORPHA:3319)
- Thrombocytopenia (HP:0001873): A reduction in the number of circulating thrombocytes. Evidence: TAS. Frequency: Very frequent (HP:0040281). (ORPHA:3319)
- Anemia (HP:0001903): A reduction in erythrocytes volume or hemoglobin concentration. Evidence: TAS. Frequency: Frequent (HP:0040282). (ORPHA:3319)
- Scoliosis (HP:0002650): The presence of an abnormal lateral curvature of the spine. Evidence: TAS. Frequency: Frequent (HP:0040282). (ORPHA:3319)
- Abnormal vertebral body morphology (HP:0003312): Abnormal form of vertebral body, which is the central cylindrical portion of the vertebra that together with other structures such as the vertebral arch, pedicles, laminae, spinous process, transverse processes, and articular facets makes up a vertebra. Evidence: TAS. Frequency: Frequent (HP:0040282). (ORPHA:3319)
- Short stature (HP:0004322): A height below that which is expected according to age and gender norms. Although there is no universally accepted definition of short stature, many refer to "short stature" as height more than 2 standard deviations below the mean for age and gender (or below the 3rd percentile for age and gender dependent norms). Evidence: TAS. Frequency: Frequent (HP:0040282). (ORPHA:3319)
- Decreased skull ossification (HP:0004331): A reduction in the magnitude or amount of ossification of the skull. Evidence: TAS. Frequency: Occasional (HP:0040283). (ORPHA:3319)
- Abnormal hemoglobin (HP:0011902): Anomaly in the level or the function of hemoglobin, the oxygen-carrying protein of erythrocytes. Evidence: TAS. Frequency: Very frequent (HP:0040281). (ORPHA:3319)